- Atypical behavior (HP:0000708): Atypical behavior is an abnormality in a person's actions that can be controlled or modulated by the will of the individual. While abnormal behaviors can be difficult to control, they are distinct from other abnormal actions that cannot be affected by the individual's will. Evidence: TAS. Frequency: Very frequent (HP:0040281). (ORPHA:85295)
- Intellectual disability (HP:0001249): The term intellectual disability or intellectual developmental disorder is used to describe significantly sub-average intellectual and adaptive functioning based on clinical assessment and as measured by individually administered, appropriately normed, standardized and validated tests of intellectual functioning and adaptive behavior, with onset during the developmental period from infancy through adolescence. Evidence: TAS. Frequency: Very frequent (HP:0040281). (ORPHA:85295)
- Abnormality of movement (HP:0100022): An abnormality of movement with a neurological basis characterized by changes in coordination and speed of voluntary movements. Evidence: TAS. Frequency: Very frequent (HP:0040281). (ORPHA:85295)
These phenotypes are associated with the disease HSD10 disease, atypical type (ORPHA:85295).